Phenotypes associated with the disease mitochondrial complex I deficiency, nuclear type 39 (OMIM:620135):
- Oligohydramnios (HP:0001562): Diminished amniotic fluid volume in pregnancy. Evidence: PCS. Frequency: 1/1. (PMID:33502047)
- Dysplastic corpus callosum (HP:0006989): Dysplasia and dysgenesis of the corpus callosum are nonspecific descriptions that imply defective development of the corpus callosum. The term dysplasia is applied when the morphology of the corpus callosum is altered as a congenital trait. For instance, the corpus callosum may be hump-shaped, kinked, or a striped corpus callosum that lacks an anatomically distinct genu and splenium. Evidence: PCS. Frequency: 1/1. (PMID:33502047)
- Cardiomegaly (HP:0001640): Increased size of the heart, clinically defined as an increased transverse diameter of the cardiac silhouette that is greater than or equal to 50% of the transverse diameter of the chest (increased cardiothoracic ratio) on a posterior-anterior projection of a chest radiograph or a computed tomography. Evidence: PCS. Frequency: 1/1. (PMID:33502047)
- Elevated brain lactate level by MRS (HP:0012707): An increase in the level of lactate in the brain identified by magnetic resonance spectroscopy (MRS). Evidence: PCS. Frequency: 1/1. (PMID:33502047)
- Reduced brain N-acetyl aspartate level by MRS (HP:0012708): A decrease in the level of N-acetyl aspartate in the brain identified by magnetic resonance spectroscopy (MRS). Evidence: PCS. Frequency: 1/1. (PMID:33502047)
- Decreased activity of mitochondrial complex I (HP:0011923): A reduction in the activity of the mitochondrial respiratory chain complex I, which is part of the electron transport chain in mitochondria. Evidence: PCS. Frequency: 1/1. (PMID:33502047)
- Small for gestational age (HP:0001518): Smaller than normal size according to sex and gestational age related norms, defined as a weight below the 10th percentile for the gestational age. Evidence: PCS. Frequency: 1/1. (PMID:33502047)
- Second trimester onset (HP:0034198): This term refers to a phenotypic feature that was first observed prior to birth during the second trimester, which comprises the range of gestational ages from 14 0/7 weeks to 27 6/7 (inclusive). Evidence: PCS. Frequency: 1/1. (PMID:33502047)
- Anemia (HP:0001903): A reduction in erythrocytes volume or hemoglobin concentration. Evidence: PCS. Frequency: 1/1. (PMID:33502047)
- Hypertrophic cardiomyopathy (HP:0001639): Hypertrophic cardiomyopathy (HCM) is defined by the presence of increased ventricular wall thickness or mass in the absence of loading conditions (hypertension, valve disease) sufficient to cause the observed abnormality. Evidence: PCS. Frequency: 1/1. (PMID:33502047)
- Perimembranous ventricular septal defect (HP:0011682): A ventricular septal defect that is confluent with and involves the membranous septum and is bordered by an atrioventricular valve, not including the type 3 VSDs. Evidence: PCS. Frequency: 1/1. (PMID:33502047)
- Autosomal recessive inheritance (HP:0000007): A mode of inheritance that is observed for traits related to a gene encoded on one of the autosomes (i.e., the human chromosomes 1-22) in which a trait manifests in individuals with two pathogenic alleles, either homozygotes (two copies of the same mutant allele) or compound heterozygotes (whereby each copy of a gene has a distinct mutant allele). Evidence: PCS. (PMID:33502047)
- Intrauterine growth retardation (HP:0001511): An abnormal restriction of fetal growth with fetal weight below the tenth percentile for gestational age. Evidence: PCS. Frequency: 1/1. (PMID:33502047)
- Hypospadias (HP:0000047): Abnormal position of urethral meatus on the ventral penile shaft (underside) characterized by displacement of the urethral meatus from the tip of the glans penis to the ventral surface of the penis, scrotum, or perineum. Evidence: PCS. Frequency: 1/1. (PMID:33502047)
- Atrial septal defect (HP:0001631): Atrial septal defect (ASD) is a congenital abnormality of the interatrial septum that enables blood flow between the left and right atria via the interatrial septum. Evidence: PCS. Frequency: 1/1. (PMID:33502047)
- Cryptorchidism (HP:0000028): Testis in inguinal canal. That is, absence of one or both testes from the scrotum owing to failure of the testis or testes to descend through the inguinal canal to the scrotum. Evidence: PCS. Frequency: 1/1. (PMID:33502047)
- Lactic acidosis (HP:0003128): An abnormal buildup of lactic acid in the body, leading to acidification of the blood and other bodily fluids. Evidence: PCS. Frequency: 1/1. (PMID:33502047)